- Abnormality of the dentition (HP:0000164): Any abnormality of the teeth. Evidence: TAS. Frequency: Very frequent (HP:0040281). (ORPHA:1786)
- Abnormal palate morphology (HP:0000174): Any abnormality of the palate, i.e., of roof of the mouth. Evidence: TAS. Frequency: Very frequent (HP:0040281). (ORPHA:1786)
- Microcephaly (HP:0000252): Head circumference below 2 standard deviations below the mean for age and gender. Evidence: TAS. Frequency: Very frequent (HP:0040281). (ORPHA:1786)
- Microretrognathia (HP:0000308): A form of developmental hypoplasia of the mandible in which the mandible is mislocalised posteriorly. Evidence: TAS. Frequency: Very frequent (HP:0040281). (ORPHA:1786)
- Smooth philtrum (HP:0000319): Flat skin surface, with no ridge formation in the central region of the upper lip between the nasal base and upper vermilion border. Evidence: TAS. Frequency: Very frequent (HP:0040281). (ORPHA:1786)
- High forehead (HP:0000348): An abnormally increased height of the forehead. Evidence: TAS. Frequency: Very frequent (HP:0040281). (ORPHA:1786)
- Downslanted palpebral fissures (HP:0000494): The palpebral fissure inclination is more than two standard deviations below the mean. Evidence: TAS. Frequency: Very frequent (HP:0040281). (ORPHA:1786)
- Carious teeth (HP:0000670): Caries is a multifactorial bacterial infection affecting the structure of the tooth. This term has been used to describe the presence of more than expected dental caries. Evidence: TAS. Frequency: Very frequent (HP:0040281). (ORPHA:1786)
- Brachydactyly (HP:0001156): Digits that appear disproportionately short compared to the hand/foot. The word brachydactyly is used here to describe a series distinct patterns of shortened digits (brachydactyly types A-E). This is the sense used here. Evidence: TAS. Frequency: Very frequent (HP:0040281). (ORPHA:1786)
- Mild intellectual disability (HP:0001256): Mild intellectual disability (ID) is defined as a type of ID characterized by mildly sub-average adaptive functioning and intellectual functioning, with an intelligence quotient (IQ) the range of 50-69. Evidence: TAS. Frequency: Very frequent (HP:0040281). (ORPHA:1786)
- Short nose (HP:0003196): Distance from nasion to subnasale more than two standard deviations below the mean, or alternatively, an apparently decreased length from the nasal root to the nasal tip. Evidence: TAS. Frequency: Very frequent (HP:0040281). (ORPHA:1786)
- Short palm (HP:0004279): Short palm. Evidence: TAS. Frequency: Very frequent (HP:0040281). (ORPHA:1786)
- Short stature (HP:0004322): A height below that which is expected according to age and gender norms. Although there is no universally accepted definition of short stature, many refer to "short stature" as height more than 2 standard deviations below the mean for age and gender (or below the 3rd percentile for age and gender dependent norms). Evidence: TAS. Frequency: Very frequent (HP:0040281). (ORPHA:1786)
- Finger syndactyly (HP:0006101): Webbing or fusion of the fingers, involving soft parts only or including bone structure. Bony fusions are referred to as "bony" Syndactyly if the fusion occurs in a radio-ulnar axis. Fusions of bones of the fingers in a proximo-distal axis are referred to as "Symphalangism". Evidence: TAS. Frequency: Very frequent (HP:0040281). (ORPHA:1786)
- Abnormal dermatoglyphics (HP:0007477): An abnormality of dermatoglyphs (fingerprints), which are present on fingers, palms, toes, and soles. Evidence: TAS. Frequency: Very frequent (HP:0040281). (ORPHA:1786)
- Hypoplasia of the zygomatic bone (HP:0010669): Underdevelopment of the zygomatic bone. That is, a reduction in size of the zygomatic bone, including the zygomatic process of the temporal bone of the skull, which forms part of the zygomatic arch. Evidence: TAS. Frequency: Very frequent (HP:0040281). (ORPHA:1786)
- Small hand (HP:0200055): Disproportionately small hand. Evidence: TAS. Frequency: Very frequent (HP:0040281). (ORPHA:1786)
- Cryptorchidism (HP:0000028): Testis in inguinal canal. That is, absence of one or both testes from the scrotum owing to failure of the testis or testes to descend through the inguinal canal to the scrotum. Evidence: TAS. Frequency: Frequent (HP:0040282). (ORPHA:1786)
- Intrauterine growth retardation (HP:0001511): An abnormal restriction of fetal growth with fetal weight below the tenth percentile for gestational age. Evidence: TAS. Frequency: Frequent (HP:0040282). (ORPHA:1786)
- Delayed skeletal maturation (HP:0002750): A decreased rate of skeletal maturation. Delayed skeletal maturation can be diagnosed on the basis of an estimation of the bone age from radiographs of specific bones in the human body. Evidence: TAS. Frequency: Frequent (HP:0040282). (ORPHA:1786)
- Preauricular pit (HP:0004467): Small indentation anterior to the insertion of the ear. Evidence: TAS. Frequency: Frequent (HP:0040282). (ORPHA:1786)
- Bilateral single transverse palmar creases (HP:0007598): The distal and proximal transverse palmar creases are merged into a single transverse palmar crease on both hands. Evidence: TAS. Frequency: Frequent (HP:0040282). (ORPHA:1786)
- Feeding difficulties in infancy (HP:0008872): Impaired feeding performance of an infant as manifested by difficulties such as weak and ineffective sucking, brief bursts of sucking, and falling asleep during sucking. There may be difficulties with chewing or maintaining attention. Evidence: TAS. Frequency: Frequent (HP:0040282). (ORPHA:1786)
- Abnormal hair pattern (HP:0010720): An abnormality of the distribution of hair growth. Evidence: TAS. Frequency: Frequent (HP:0040282). (ORPHA:1786)
- Inguinal hernia (HP:0000023): Protrusion of the contents of the abdominal cavity through the inguinal canal. Evidence: TAS. Frequency: Occasional (HP:0040283). (ORPHA:1786)
- Hypospadias (HP:0000047): Abnormal position of urethral meatus on the ventral penile shaft (underside) characterized by displacement of the urethral meatus from the tip of the glans penis to the ventral surface of the penis, scrotum, or perineum. Evidence: TAS. Frequency: Occasional (HP:0040283). (ORPHA:1786)
- Webbed neck (HP:0000465): Pterygium colli is a congenital skin fold that runs along the sides of the neck down to the shoulders. It involves an ectopic fibrotic facial band superficial to the trapezius muscle. Excess hair-bearing skin is also present and extends down the cervical region well beyond the normal hairline. Evidence: TAS. Frequency: Occasional (HP:0040283). (ORPHA:1786)
- Pectus excavatum (HP:0000767): A defect of the chest wall characterized by a depression of the sternum, giving the chest ("pectus") a caved-in ("excavatum") appearance. Evidence: TAS. Frequency: Occasional (HP:0040283). (ORPHA:1786)
- Premature birth (HP:0001622): The birth of a baby of less than 37 weeks of gestational age. Evidence: TAS. Frequency: Occasional (HP:0040283). (ORPHA:1786)
- Tessier cleft (HP:0002006): A congenital malformation with a cleft (gap or opening) in the face. Evidence: TAS. Frequency: Occasional (HP:0040283). (ORPHA:1786)
- Coarse hair (HP:0002208): Hair shafts are rough in texture. Evidence: TAS. Frequency: Occasional (HP:0040283). (ORPHA:1786)
- Spina bifida occulta (HP:0003298): The closed form of spina bifida with incomplete closure of a vertebral body with intact overlying skin. Evidence: TAS. Frequency: Occasional (HP:0040283). (ORPHA:1786)
- Clinodactyly of the 5th finger (HP:0004209): Clinodactyly refers to a bending or curvature of the fifth finger in the radial direction (i.e., towards the 4th finger). Evidence: TAS. Frequency: Occasional (HP:0040283). (ORPHA:1786)
- Tooth agenesis (HP:0009804): The absence of one or more teeth from the normal series by a failure to develop. Evidence: TAS. Frequency: Occasional (HP:0040283). (ORPHA:1786)
- Posteriorly rotated ears (HP:0000358): A type of abnormal location of the ears in which the position of the ears is characterized by posterior rotation (the superior part of the ears is rotated towards the back of the head, and the inferior part of the ears towards the front). Evidence: TAS. Frequency: Frequent (HP:0040282). (ORPHA:1786)
These phenotypes are associated with the disease Acrofacial dysostosis, Catania type (ORPHA:1786).